Phenotypes associated with the disease canine teeth, absence of upper permanent (OMIM:114600):
- Agenesis of canine (HP:0012738): Agenesis of canine tooth. Evidence: TAS. (OMIM:114600)
- Autosomal dominant inheritance (HP:0000006): A mode of inheritance that is observed for traits related to a gene encoded on one of the autosomes (i.e., the human chromosomes 1-22) in which a trait manifests in heterozygotes. In the context of medical genetics, an autosomal dominant disorder is caused when a single copy of the mutant allele is present. Males and females are affected equally, and can both transmit the disorder with a risk of 50% for each child of inheriting the mutant allele. Evidence: TAS. (OMIM:114600)